Phenotypes associated with the disease Fetal minoxidil syndrome (ORPHA:1918):
- Cryptorchidism (HP:0000028): Testis in inguinal canal. That is, absence of one or both testes from the scrotum owing to failure of the testis or testes to descend through the inguinal canal to the scrotum. Evidence: TAS. Frequency: Very frequent (HP:0040281). (ORPHA:1918)
- Micrognathia (HP:0000347): Developmental hypoplasia of the mandible. Evidence: TAS. Frequency: Very frequent (HP:0040281). (ORPHA:1918)
- Umbilical hernia (HP:0001537): Protrusion of abdominal contents through a defect in the abdominal wall musculature around the umbilicus. Skin and subcutaneous tissue overlie the defect. Evidence: TAS. Frequency: Very frequent (HP:0040281). (ORPHA:1918)
- Ventricular septal defect (HP:0001629): A hole between the two bottom chambers (ventricles) of the heart. The defect is centered around the most superior aspect of the ventricular septum. Evidence: TAS. Frequency: Very frequent (HP:0040281). (ORPHA:1918)
- Generalized hirsutism (HP:0002230): Abnormally increased hair growth over much of the entire body. Evidence: TAS. Frequency: Very frequent (HP:0040281). (ORPHA:1918)
- Clinodactyly of the 5th finger (HP:0004209): Clinodactyly refers to a bending or curvature of the fifth finger in the radial direction (i.e., towards the 4th finger). Evidence: TAS. Frequency: Very frequent (HP:0040281). (ORPHA:1918)
- Depressed nasal bridge (HP:0005280): Posterior positioning of the nasal root in relation to the overall facial profile for age. Evidence: TAS. Frequency: Very frequent (HP:0040281). (ORPHA:1918)
- Posteriorly rotated ears (HP:0000358): A type of abnormal location of the ears in which the position of the ears is characterized by posterior rotation (the superior part of the ears is rotated towards the back of the head, and the inferior part of the ears towards the front). Evidence: TAS. Frequency: Very frequent (HP:0040281). (ORPHA:1918)